Phenotypes associated with the disease Post-transplant lymphoproliferative disease (ORPHA:70568):
- Abnormality of the voice (HP:0001608). Evidence: TAS. Frequency: Frequent (HP:0040282). (ORPHA:70568)
- Weight loss (HP:0001824): Reduction of total body weight. Evidence: TAS. Frequency: Frequent (HP:0040282). (ORPHA:70568)
- Fever (HP:0001945): Body temperature elevated above the normal range. Evidence: TAS. Frequency: Frequent (HP:0040282). (ORPHA:70568)
- Lymphadenopathy (HP:0002716): Enlargement (swelling) of a lymph node. Evidence: TAS. Frequency: Frequent (HP:0040282). (ORPHA:70568)
- Poor appetite (HP:0004396): A reduced desire to eat. Evidence: TAS. Frequency: Frequent (HP:0040282). (ORPHA:70568)
- Fatigue (HP:0012378): A subjective feeling of tiredness characterized by a lack of energy and motivation. Evidence: TAS. Frequency: Frequent (HP:0040282). (ORPHA:70568)
- Snoring (HP:0025267): Deep, noisy breathing during sleep, accompanied by hoarse or harsh sounds, is caused by the vibration of respiratory structures, especially the soft palate. This vibration results in sound due to obstructed air movement during breathing while sleeping. Evidence: TAS. Frequency: Frequent (HP:0040282). (ORPHA:70568)
- Night sweats (HP:0030166): Occurrence of excessive sweating during sleep. Evidence: TAS. Frequency: Frequent (HP:0040282). (ORPHA:70568)
- Pharyngalgia (HP:0033050): An unpleasant sensation characterized by physical discomfort (such as pricking, throbbing, or aching) and perceived to originate in the throat. Evidence: TAS. Frequency: Frequent (HP:0040282). (ORPHA:70568)
- Malaise (HP:0033834): A feeling of general discomfort, weakness, or lack of health. Evidence: TAS. Frequency: Frequent (HP:0040282). (ORPHA:70568)
- Diarrhea (HP:0002014): Abnormally increased frequency (usually defined as three or more) loose or watery bowel movements a day. Evidence: TAS. Frequency: Occasional (HP:0040283). (ORPHA:70568)
- Abdominal pain (HP:0002027): An unpleasant sensation characterized by physical discomfort (such as pricking, throbbing, or aching) and perceived to originate in the abdomen. Evidence: TAS. Frequency: Occasional (HP:0040283). (ORPHA:70568)
- Gastrointestinal hemorrhage (HP:0002239): Hemorrhage affecting the gastrointestinal tract. Evidence: TAS. Frequency: Occasional (HP:0040283). (ORPHA:70568)
- Hypoalbuminemia (HP:0003073): The concentration of albumin in the blood circulation is below the lower limit of normal. Evidence: TAS. Frequency: Occasional (HP:0040283). (ORPHA:70568)
- Hepatitis (HP:0012115): Inflammation of the liver. Evidence: TAS. Frequency: Occasional (HP:0040283). (ORPHA:70568)
- Pulmonary nodule (HP:0033608): Focal rounded or ovoid opacity, not more than 3 cm in diameter. Pulmonary nodules are typically observed by chest radiography or computer tomography imaging. Evidence: TAS. Frequency: Occasional (HP:0040283). (ORPHA:70568)